Phenotypes associated with the disease spermatogenic failure 47 (OMIM:619102):
- Male infertility (HP:0003251). Evidence: PCS. Frequency: 2/2. (PMID:32051257)
- Autosomal recessive inheritance (HP:0000007): A mode of inheritance that is observed for traits related to a gene encoded on one of the autosomes (i.e., the human chromosomes 1-22) in which a trait manifests in individuals with two pathogenic alleles, either homozygotes (two copies of the same mutant allele) or compound heterozygotes (whereby each copy of a gene has a distinct mutant allele). Evidence: PCS. (PMID:32051257)
- Immotile sperm (HP:0012208): A lack of mobility of ejaculated sperm. Evidence: PCS. Frequency: 2/2. (PMID:32051257)
- Absent sperm flagella (HP:0032558): Sperm cells lacking flagella. Evidence: PCS. Frequency: 2/2. (PMID:32051257)
- Oligozoospermia (HP:0000798): Reduced count of spermatozoa in the semen, defined as a sperm count below 20 million per milliliter semen. Evidence: PCS. Frequency: 2/2. (PMID:32051257)
- Short sperm flagella (HP:0032559): Sperm cells with abnormally short flagella. Evidence: PCS. Frequency: 2/2. (PMID:32051257)